- Menorrhagia (HP:0000132): Prolonged and excessive menses at regular intervals in excess of 80 mL or lasting longer than 7 days. Evidence: TAS. Frequency: Occasional (HP:0040283). (ORPHA:397685)
- Female hypogonadism (HP:0000134): Decreased functionality of the female gonads, i.e., of the ovary. Evidence: TAS. Frequency: Occasional (HP:0040283). (ORPHA:397685)
- Amenorrhea (HP:0000141): Absence of menses for an interval of time equivalent to a total of more than (or equal to) 3 previous cycles or 6 months. Evidence: TAS. Frequency: Frequent (HP:0040282). (ORPHA:397685)
- Infertility (HP:0000789). Evidence: TAS. Frequency: Frequent (HP:0040282). (ORPHA:397685)
- Oligomenorrhea (HP:0000876): Infrequent menses (less than 6 per year or more than 35 days between cycles). Evidence: TAS. Frequency: Very frequent (HP:0040281). (ORPHA:397685)
- Osteopenia (HP:0000938): Osteopenia is a term to define bone density that is not normal but also not as low as osteoporosis. By definition from the World Health Organization osteopenia is defined by bone densitometry as a T score -1 to -2.5. Evidence: TAS. Frequency: Occasional (HP:0040283). (ORPHA:397685)
- Osteoporosis (HP:0000939): Osteoporosis is a systemic skeletal disease characterized by low bone density and microarchitectural deterioration of bone tissue with a consequent increase in bone fragility. According to the WHO criteria, osteoporosis is defined as a BMD that lies 2.5 standard deviations or more below the average value for young healthy adults (a T-score below -2.5 SD). Evidence: TAS. Frequency: Occasional (HP:0040283). (ORPHA:397685)
- Hemorrhagic ovarian cyst (HP:0012886): An abdominal mass formed by bleeding into a follicular ovarian cyst or corpus luteum cyst. Evidence: TAS. Frequency: Frequent (HP:0040282). (ORPHA:397685)
- Galactorrhea (HP:0100829): Spontaneous flow of milk from the breast, unassociated with childbirth or nursing. Evidence: TAS. Frequency: Very frequent (HP:0040281). (ORPHA:397685)
These phenotypes are associated with the disease Familial hyperprolactinemia (ORPHA:397685).